Phenotypes associated with the disease myasthenia gravis (OMIM:254200):
- Autoimmunity (HP:0002960): The occurrence of an immune reaction against the organism's own cells or tissues. Evidence: TAS. (OMIM:254200)
- Impaired mastication (HP:0005216): An abnormal reduction in the ability to masticate (chew), i.e., in the ability to crush and ground food in preparation for swallowing. Evidence: IEA. (OMIM:254200)
- Dysphagia (HP:0002015): Difficulty in swallowing. Evidence: IEA. (OMIM:254200)
- Facial palsy (HP:0010628): Facial nerve palsy is a dysfunction of cranial nerve VII (the facial nerve) that results in inability to control facial muscles on the affected side with weakness of the muscles of facial expression and eye closure. This can either be present in unilateral or bilateral form. Evidence: IEA. (OMIM:254200)
- Diplopia (HP:0000651): Diplopia is a condition in which a single object is perceived as two images, it is also known as double vision. Evidence: IEA. (OMIM:254200)
- Fatigable weakness (HP:0003473): A type of weakness that occurs after a muscle group is used and lessens if the muscle group has some rest. That is, there is diminution of strength with repetitive muscle actions. Evidence: TAS. (OMIM:254200)
- Dysarthria (HP:0001260): Dysarthric speech is a general description referring to a neurological speech disorder characterized by poor articulation. Depending on the involved neurological structures, dysarthria may be further classified as spastic, flaccid, ataxic, hyperkinetic and hypokinetic, or mixed. Evidence: IEA. (OMIM:254200)
- Limb muscle weakness (HP:0003690): Reduced strength and weakness of the muscles of the arms and legs. Evidence: IEA. (OMIM:254200)
- Abnormality of the endocrine system (HP:0000818): An abnormality of the endocrine system. Evidence: IEA. (OMIM:254200)
- Thymoma (HP:0100522): A tumor originating from the epithelial cells of the thymus. Evidence: TAS. (OMIM:254200)
- Ptosis (HP:0000508): The upper eyelid margin is positioned 3 mm or more lower than usual and covers the superior portion of the iris (objective); or, the upper lid margin obscures at least part of the pupil (subjective). Evidence: IEA. (OMIM:254200)
- Abnormality of the immune system (HP:0002715): An abnormality of the immune system. Evidence: IEA. (OMIM:254200)
- Non-Mendelian inheritance (HP:0001426): A mode of inheritance that depends on genetic determinants in more than one gene. Evidence: TAS. (OMIM:254200)
- Proximal muscle weakness (HP:0003701): A lack of strength of the proximal muscles. Evidence: IEA. (OMIM:254200)
- Hypernasal speech (HP:0001611): A type of speech characterized by the presence of an abnormally increased nasal airflow during speech associated with structural abnormality of the nasal passages. Evidence: IEA. (OMIM:254200)